Phenotypes associated with the disease Wilms tumor 1 (OMIM:194070):
- Typified by somatic mosaicism (HP:0001442): Description of conditions in which affected individuals typically display somatic mosaicism, i.e., genetically distinct populations of somatic cells in a given organism caused by DNA mutations, epigenetic alterations of DNA, chromosomal abnormalities or the spontaneous reversion of inherited mutations. In many conditions typified by somatic mosaicism, constitutive mutation is lethal and cases are exclusively or predominantly mosaic. Evidence: IEA. (OMIM:194070)
- Nephroblastoma (HP:0002667): The presence of a nephroblastoma, which is a neoplasm of the kidney that primarily affects children. Evidence: IEA. (OMIM:194070)
- Autosomal dominant inheritance (HP:0000006): A mode of inheritance that is observed for traits related to a gene encoded on one of the autosomes (i.e., the human chromosomes 1-22) in which a trait manifests in heterozygotes. In the context of medical genetics, an autosomal dominant disorder is caused when a single copy of the mutant allele is present. Males and females are affected equally, and can both transmit the disorder with a risk of 50% for each child of inheriting the mutant allele. Evidence: IEA. (OMIM:194070)